- Inability to walk (HP:0002540): Incapability to ambulate. Evidence: TAS. (OMIM:209100)
- Abasia (HP:0012651): A severe form of gait ataxia such that an affected person cannot walk at all. Evidence: TAS. (OMIM:209100)
- Hypotonia (HP:0001252): Hypotonia is an abnormally low muscle tone (the amount of tension or resistance to movement in a muscle). Even when relaxed, muscles have a continuous and passive partial contraction which provides some resistance to passive stretching. Hypotonia thus manifests as diminished resistance to passive stretching. Hypotonia is not the same as muscle weakness, although the two conditions can co-exist. Evidence: IEA. (OMIM:209100)
- Ataxia (HP:0001251): Ataxia refers to impaired coordination of voluntary muscle movement. Cerebellar ataxia refers to ataxia due to dysfunction of the cerebellum. This causes a variety of elementary neurological deficits including asynergy (lack of coordination between muscles, limbs and joints), dysmetria (lack of ability to judge distances that can lead to under- or overshoot in grasping movements), and dysdiadochokinesia (inability to perform rapid movements requiring antagonizing muscle groups to be switched on and off repeatedly). Evidence: IEA. (OMIM:209100)
- Generalized hypotonia (HP:0001290): Generalized muscular hypotonia (abnormally low muscle tone). Evidence: TAS. (OMIM:209100)
- Autosomal recessive inheritance (HP:0000007): A mode of inheritance that is observed for traits related to a gene encoded on one of the autosomes (i.e., the human chromosomes 1-22) in which a trait manifests in individuals with two pathogenic alleles, either homozygotes (two copies of the same mutant allele) or compound heterozygotes (whereby each copy of a gene has a distinct mutant allele). Evidence: IEA. (OMIM:209100)
These phenotypes are associated with the disease atonic-astatic syndrome of Foerster (OMIM:209100).